Phenotypes associated with the disease intellectual disability, autosomal recessive 54 (OMIM:617028):
- Exaggerated startle response (HP:0002267): An exaggerated startle reaction in response to a sudden unexpected visual or acoustic stimulus, or a quick movement near the face. Evidence: PCS. Frequency: 1/4. (PMID:27106596)
- Delayed speech and language development (HP:0000750): A degree of language development that is significantly below the norm for a child of a specified age. Evidence: PCS. (PMID:27106596)
- Infantile onset (HP:0003593): Onset of signs or symptoms of disease between 28 days to one year of life. Evidence: PCS. Frequency: 4/4. (PMID:27106596)
- Emotional lability (HP:0000712): Unstable emotional experiences and frequent mood changes; emotions that are easily aroused, intense, and/or disproportionate to events and circumstances. Evidence: PCS. Frequency: 1/4. (PMID:27106596)
- Autosomal recessive inheritance (HP:0000007): A mode of inheritance that is observed for traits related to a gene encoded on one of the autosomes (i.e., the human chromosomes 1-22) in which a trait manifests in individuals with two pathogenic alleles, either homozygotes (two copies of the same mutant allele) or compound heterozygotes (whereby each copy of a gene has a distinct mutant allele). Evidence: PCS. (PMID:27106596)
- Attention deficit hyperactivity disorder (HP:0007018): Attention deficit hyperactivity disorder (ADHD) manifests at age 2-3 years or by first grade at the latest. The main symptoms are distractibility, impulsivity, hyperactivity, and often trouble organizing tasks and projects, difficulty going to sleep, and social problems from being aggressive, loud, or impatient. Evidence: PCS. Frequency: 1/4. (PMID:27106596)
- Intellectual disability (HP:0001249): The term intellectual disability or intellectual developmental disorder is used to describe significantly sub-average intellectual and adaptive functioning based on clinical assessment and as measured by individually administered, appropriately normed, standardized and validated tests of intellectual functioning and adaptive behavior, with onset during the developmental period from infancy through adolescence. Evidence: PCS. Frequency: 4/4. (PMID:27106596)